- Autosomal recessive inheritance (HP:0000007): A mode of inheritance that is observed for traits related to a gene encoded on one of the autosomes (i.e., the human chromosomes 1-22) in which a trait manifests in individuals with two pathogenic alleles, either homozygotes (two copies of the same mutant allele) or compound heterozygotes (whereby each copy of a gene has a distinct mutant allele). Evidence: IEA. (OMIM:248310)
This phenotype is associated with the disease PLASMODIUM FALCIPARUM BLOOD INFECTION LEVEL (OMIM:248310).